Phenotypes associated with the disease spinocerebellar ataxia type 31 (OMIM:117210):
- Gaze-evoked horizontal nystagmus (HP:0007979): Horizontal nystagmus made apparent by looking to the right or to the left. Evidence: TAS. Frequency: Frequent (HP:0040282). (OMIM:117210)
- Nystagmus (HP:0000639): Rhythmic, involuntary oscillations of one or both eyes related to abnormality in fixation, conjugate gaze, or vestibular mechanisms. Evidence: TAS. (OMIM:117210)
- Cerebellar atrophy (HP:0001272): Cerebellar atrophy is defined as a cerebellum with initially normal structures, in a posterior fossa with normal size, which displays enlarged fissures (interfolial spaces) in comparison to the foliae secondary to loss of tissue. Cerebellar atrophy implies irreversible loss of tissue and result from an ongoing progressive disease until a final stage is reached or a single injury, e.g. an intoxication or infectious event. Evidence: TAS. (OMIM:117210)
- Dysarthria (HP:0001260): Dysarthric speech is a general description referring to a neurological speech disorder characterized by poor articulation. Depending on the involved neurological structures, dysarthria may be further classified as spastic, flaccid, ataxic, hyperkinetic and hypokinetic, or mixed. Evidence: IEA. (OMIM:117210)
- Gait ataxia (HP:0002066): A type of ataxia characterized by the impairment of the ability to coordinate the movements required for normal walking. Gait ataxia is characteirzed by a wide-based staggering gait with a tendency to fall. Evidence: IEA. (OMIM:117210)
- Sensorineural hearing impairment (HP:0000407): A type of hearing impairment in one or both ears related to an abnormal functionality of the cochlear nerve. Evidence: TAS. Frequency: Occasional (HP:0040283). (OMIM:117210)
- Late onset (HP:0003584): A type of adult onset with onset of symptoms after the age of 60 years. Evidence: TAS. Frequency: Frequent (HP:0040282). (OMIM:117210)
- Ataxia (HP:0001251): Ataxia refers to impaired coordination of voluntary muscle movement. Cerebellar ataxia refers to ataxia due to dysfunction of the cerebellum. This causes a variety of elementary neurological deficits including asynergy (lack of coordination between muscles, limbs and joints), dysmetria (lack of ability to judge distances that can lead to under- or overshoot in grasping movements), and dysdiadochokinesia (inability to perform rapid movements requiring antagonizing muscle groups to be switched on and off repeatedly). Evidence: TAS. (OMIM:117210)
- Limb ataxia (HP:0002070): A kind of ataxia that affects movements of the extremities. Evidence: IEA. (OMIM:117210)
- Autosomal dominant inheritance (HP:0000006): A mode of inheritance that is observed for traits related to a gene encoded on one of the autosomes (i.e., the human chromosomes 1-22) in which a trait manifests in heterozygotes. In the context of medical genetics, an autosomal dominant disorder is caused when a single copy of the mutant allele is present. Males and females are affected equally, and can both transmit the disorder with a risk of 50% for each child of inheriting the mutant allele. Evidence: IEA. (OMIM:117210)